Phenotypes associated with the disease Idiopathic panuveitis (ORPHA:280921):
- Abnormality of vision (HP:0000504): Abnormality of eyesight (visual perception). Evidence: TAS. Frequency: Frequent (HP:0040282). (ORPHA:280921)
- Blurred vision (HP:0000622): Lack of sharpness of vision resulting in the inability to see fine detail. Evidence: TAS. Frequency: Frequent (HP:0040282). (ORPHA:280921)
- Reduced visual acuity (HP:0007663). Evidence: TAS. Frequency: Frequent (HP:0040282). (ORPHA:280921)
- Red eye (HP:0025337): A reddish appearance over the white part (sclera) of the eye ranging from a few enlarged blood vessels appearing as wiggly lines over the sclera to a bright red color completely covering to sclera. Evidence: TAS. Frequency: Frequent (HP:0040282). (ORPHA:280921)
- Vitreous haze (HP:0030652): Vitreous haze is the obscuration of fundus details by vitreous cells and protein exudation. Evidence: TAS. Frequency: Frequent (HP:0040282). (ORPHA:280921)
- Ocular pain (HP:0200026): An unpleasant sensation characterized by physical discomfort (such as pricking, throbbing, or aching) localized to the eye. Evidence: TAS. Frequency: Frequent (HP:0040282). (ORPHA:280921)
- Cataract (HP:0000518): A cataract is an opacity or clouding that develops in the crystalline lens of the eye or in its capsule. Evidence: TAS. Frequency: Occasional (HP:0040283). (ORPHA:280921)
- Photophobia (HP:0000613): Excessive sensitivity to light with the sensation of discomfort or pain in the eyes due to exposure to bright light. Evidence: TAS. Frequency: Occasional (HP:0040283). (ORPHA:280921)
- Miosis (HP:0000616): Abnormal (non-physiological) constriction of the pupil. Evidence: TAS. Frequency: Occasional (HP:0040283). (ORPHA:280921)
- Headache (HP:0002315): Cephalgia, or pain sensed in various parts of the head, not confined to the area of distribution of any nerve. Evidence: TAS. Frequency: Occasional (HP:0040283). (ORPHA:280921)
- Posterior synechiae of the anterior chamber (HP:0011484): Adhesions between the iris and the lens. Evidence: TAS. Frequency: Occasional (HP:0040283). (ORPHA:280921)
- Cystoid macular edema (HP:0011505): Cystoid thickening of the retina that takes place due to accumulation of extracellular fluid in the macula as a nonspecific response to blood-retinal barrier breakdown. Histological studies show that radially orientated cystoid spaces consisting of ophthalmoscopically clear fluid are often clinically detectable in the macula area. Evidence: TAS. Frequency: Occasional (HP:0040283). (ORPHA:280921)
- Vitreous snowballs (HP:0030661): Yellow-white inflammatory aggregates in the vitreous that are found in the midvitreous and inferior periphery. Evidence: TAS. Frequency: Occasional (HP:0040283). (ORPHA:280921)
- Conjunctival hyperemia (HP:0030953): Dilatation of the blood vessels of the conjunctiva leading to a red appearance of the sclera. Evidence: TAS. Frequency: Occasional (HP:0040283). (ORPHA:280921)
- Vitreous floaters (HP:0100832): Deposits of various size, shape, consistency, refractive index, and motility within the eye's vitreous humor, which is normally transparent. Evidence: TAS. Frequency: Occasional (HP:0040283). (ORPHA:280921)
- Blindness (HP:0000618): Blindness is the condition of lacking visual perception defined as a profound reduction in visual perception. On the 6m visual acuity scale, blindness is defined as less than 3/60. On the 20ft visual acuity scale, blindness is defined as less than 20/400. On the decimal visual acuity scale, blindness is defined as less than 0.05. Blindness is typically characterized by a visual field of no greater than 10 degrees in radius around central fixation. Evidence: TAS. Frequency: Very rare (HP:0040284). (ORPHA:280921)
- Ocular hypertension (HP:0007906): Intraocular pressure that is 2 standard deviations above the population mean. Evidence: TAS. Frequency: Very rare (HP:0040284). (ORPHA:280921)
- Choroidal neovascularization (HP:0011506): Choroidal neovascularization (CNV) is the inward growth of new blood vessels arising from the choriocapillaris. Depending on the stage of development, they can be external (type 1 NV) or internal (type 2 NV) to the retinal pigment epithelium. Evidence: TAS. Frequency: Very rare (HP:0040284). (ORPHA:280921)
- Epiretinal membrane (HP:0100014): An epiretinal membrane is a thin sheet of fibrous tissue on the surface of the retina along the inner limiting membrane. It appears as a greyish semi-translucent avascular membrane over the internal limiting membrane (ILM) on the surface of the retina. Evidence: TAS. Frequency: Very rare (HP:0040284). (ORPHA:280921)